Phenotypes associated with the disease SLC39A8-CDG (OMIM:616721):
- Poor head control (HP:0002421): Difficulty to maintain correct position of the head while standing or sitting. Infant head lag is observed when the head seems to flop around or lags posteriorly behind the trunk. Several articles have maintained that head lag should be absent by age 3 to 4 months. Evidence: PCS. Frequency: 8/8. (PMID:26637978)
- Astigmatism (HP:0000483): A type of refraction error associated with abnormal curvatures on the anterior and/or posterior surface of the cornea. Evidence: TAS. (OMIM:616721)
- Cerebral atrophy (HP:0002059): Atrophy (wasting, decrease in size of cells or tissue) affecting the cerebrum. Evidence: PCS. Frequency: 1/7. (PMID:26637978)
- Congenital onset (HP:0003577): A phenotypic abnormality that is present at birth. Evidence: PCS. (PMID:26637978)
- Craniosynostosis (HP:0001363): Craniosynostosis refers to the premature closure of the cranial sutures. Primary craniosynostosis refers to the closure of one or more sutures due to abnormalities in skull development, and secondary craniosynostosis results from failure of brain growth. Evidence: TAS. Frequency: Occasional (HP:0040283). (OMIM:616721)
- Hearing impairment (HP:0000365): A decreased magnitude of the sensory perception of sound. Evidence: TAS. Frequency: Occasional (HP:0040283). (OMIM:616721)
- Inability to walk (HP:0002540): Incapability to ambulate. Evidence: PCS. Frequency: 6/8. (PMID:26637978)
- Strabismus (HP:0000486): A misalignment of the eyes so that the visual axes deviate from bifoveal fixation. The classification of strabismus may be based on a number of features including the relative position of the eyes, whether the deviation is latent or manifest, intermittent or constant, concomitant or otherwise and according to the age of onset and the relevance of any associated refractive error. Evidence: PCS. Frequency: 7/8. (PMID:26637978)
- Short stature (HP:0004322): A height below that which is expected according to age and gender norms. Although there is no universally accepted definition of short stature, many refer to "short stature" as height more than 2 standard deviations below the mean for age and gender (or below the 3rd percentile for age and gender dependent norms). Evidence: PCS. Frequency: 3/8. (PMID:26637978)
- Cerebellar atrophy (HP:0001272): Cerebellar atrophy is defined as a cerebellum with initially normal structures, in a posterior fossa with normal size, which displays enlarged fissures (interfolial spaces) in comparison to the foliae secondary to loss of tissue. Cerebellar atrophy implies irreversible loss of tissue and result from an ongoing progressive disease until a final stage is reached or a single injury, e.g. an intoxication or infectious event. Evidence: PCS. Frequency: 7/7. (PMID:26637978)
- Joint hypermobility (HP:0001382): The capability that a joint (or a group of joints) has to move, passively and/or actively, beyond normal limits along physiological axes. Evidence: PCS. Frequency: 2/8. (PMID:26637978)
- Seizure (HP:0001250): A seizure is an intermittent abnormality of nervous system physiology characterized by a transient occurrence of signs and/or symptoms due to abnormal excessive or synchronous neuronal activity in the brain. Evidence: PCS. Frequency: 2/8. (PMID:26637978)
- Profound intellectual disability (HP:0002187): Profound intellectual disability (ID) is defined as a type of ID characterized by profoundly sub-average adaptive functioning and intellectual functioning, with an intelligence quotient (IQ) below 20. Evidence: PCS. Frequency: 5/8. (PMID:26637978)
- Global developmental delay (HP:0001263): A delay in the achievement of motor or mental milestones in the domains of development of a child, including motor skills, speech and language, cognitive skills, and social and emotional skills. This term should only be used to describe children younger than five years of age. Evidence: PCS. (PMID:26637978)
- Hypotonia (HP:0001252): Hypotonia is an abnormally low muscle tone (the amount of tension or resistance to movement in a muscle). Even when relaxed, muscles have a continuous and passive partial contraction which provides some resistance to passive stretching. Hypotonia thus manifests as diminished resistance to passive stretching. Hypotonia is not the same as muscle weakness, although the two conditions can co-exist. Evidence: PCS. Frequency: 8/8. (PMID:26637978)
- Elevated brain lactate level by MRS (HP:0012707): An increase in the level of lactate in the brain identified by magnetic resonance spectroscopy (MRS). Evidence: PCS. Frequency: 1/2. (PMID:26637978)
- Nystagmus (HP:0000639): Rhythmic, involuntary oscillations of one or both eyes related to abnormality in fixation, conjugate gaze, or vestibular mechanisms. Evidence: TAS. (OMIM:616721)
- Recurrent infections (HP:0002719): Increased susceptibility to infections as manifested by repeated bouts of infection. Evidence: PCS. Frequency: 5/8. (PMID:26637978)
- Osteopenia (HP:0000938): Osteopenia is a term to define bone density that is not normal but also not as low as osteoporosis. By definition from the World Health Organization osteopenia is defined by bone densitometry as a T score -1 to -2.5. Evidence: PCS. Frequency: 2/3. (PMID:26637978)
- Autosomal recessive inheritance (HP:0000007): A mode of inheritance that is observed for traits related to a gene encoded on one of the autosomes (i.e., the human chromosomes 1-22) in which a trait manifests in individuals with two pathogenic alleles, either homozygotes (two copies of the same mutant allele) or compound heterozygotes (whereby each copy of a gene has a distinct mutant allele). Evidence: PCS. (PMID:26637978)
- Delayed ability to sit (HP:0025336): A failure to achieve the ability to sit at an appropriate developmental stage. Most children sit with support at 6 months of age and sit steadily without support at 9 months of age. Evidence: PCS. Frequency: 8/8. (PMID:26637978)
- Intellectual disability (HP:0001249): The term intellectual disability or intellectual developmental disorder is used to describe significantly sub-average intellectual and adaptive functioning based on clinical assessment and as measured by individually administered, appropriately normed, standardized and validated tests of intellectual functioning and adaptive behavior, with onset during the developmental period from infancy through adolescence. Evidence: PCS. Frequency: 8/8. (PMID:26637978)
- Hyperreflexia (HP:0001347): Hyperreflexia is the presence of hyperactive stretch reflexes of the muscles. Evidence: PCS. Frequency: 2/8. (PMID:26637978)
- Cerebellar vermis atrophy (HP:0006855): Wasting (atrophy) of the vermis of cerebellum. Evidence: PCS. Frequency: 7/7. (PMID:26637978)